- Hemolytic anemia (HP:0001878): A type of anemia caused by premature destruction of red blood cells (hemolysis). Evidence: IEA. (OMIM:172150)
- Autosomal dominant inheritance (HP:0000006): A mode of inheritance that is observed for traits related to a gene encoded on one of the autosomes (i.e., the human chromosomes 1-22) in which a trait manifests in heterozygotes. In the context of medical genetics, an autosomal dominant disorder is caused when a single copy of the mutant allele is present. Males and females are affected equally, and can both transmit the disorder with a risk of 50% for each child of inheriting the mutant allele. Evidence: IEA. (OMIM:172150)
These phenotypes are associated with the disease 6-phosphogluconolactonase deficiency (OMIM:172150).